- Ptosis (HP:0000508): The upper eyelid margin is positioned 3 mm or more lower than usual and covers the superior portion of the iris (objective); or, the upper lid margin obscures at least part of the pupil (subjective). Evidence: TAS. Frequency: Frequent (HP:0040282). (ORPHA:230800)
- Diplopia (HP:0000651): Diplopia is a condition in which a single object is perceived as two images, it is also known as double vision. Evidence: TAS. Frequency: Frequent (HP:0040282). (ORPHA:230800)
- Muscle weakness (HP:0001324): Reduced strength of muscles. Evidence: TAS. Frequency: Very frequent (HP:0040281). (ORPHA:230800)
- Dysphagia (HP:0002015): Difficulty in swallowing. Evidence: TAS. Frequency: Frequent (HP:0040282). (ORPHA:230800)
- Constipation (HP:0002019): Infrequent or difficult evacuation of feces. Evidence: TAS. Frequency: Very frequent (HP:0040281). (ORPHA:230800)
- Dyspnea (HP:0002094): Difficult or labored breathing. Dyspnea is a subjective feeling only the patient can rate, e.g., on a Borg scale. Evidence: TAS. Frequency: Frequent (HP:0040282). (ORPHA:230800)
- Respiratory insufficiency due to muscle weakness (HP:0002747). Evidence: TAS. Frequency: Frequent (HP:0040282). (ORPHA:230800)
- Paralysis (HP:0003470): Paralysis of voluntary muscles means loss of contraction due to interruption of one or more motor pathways from the brain to the muscle fibers. Although the word paralysis is often used interchangeably to mean either complete or partial loss of muscle strength, it is preferable to use paralysis or plegia for complete or severe loss of muscle strength, and paresis for partial or slight loss. Motor paralysis results from deficits of the upper motor neurons (corticospinal, corticobulbar, or subcorticospinal). Motor paralysis is often accompanied by an impairment in the facility of movement. Evidence: TAS. Frequency: Very frequent (HP:0040281). (ORPHA:230800)
- Diaphragmatic paralysis (HP:0006597): The presence of a paralyzed diaphragm. Evidence: TAS. Frequency: Very frequent (HP:0040281). (ORPHA:230800)
- Cranial nerve paralysis (HP:0006824). Evidence: TAS. Frequency: Very frequent (HP:0040281). (ORPHA:230800)
- Mydriasis (HP:0011499): Abnormal dilatation of the iris. Evidence: TAS. Frequency: Very frequent (HP:0040281). (ORPHA:230800)
- Cerebral palsy (HP:0100021): Cerebral palsy describes a group of permanent disorders of the development of movement and posture, causing activity limitation, that are attributed to nonprogressive disturbances that occurred in the developing fetal or infant brain. The motor disorders of cerebral palsy are often accompanied by disturbances of sensation, perception, cognition, communication, and behavior, by epilepsy, and by secondary musculoskeletal problems. Evidence: TAS. Frequency: Very frequent (HP:0040281). (ORPHA:230800)
These phenotypes are associated with the disease Toxin-mediated infectious botulism (ORPHA:230800).